- Fever (HP:0001945): Body temperature elevated above the normal range. Evidence: TAS. Frequency: Very frequent (HP:0040281). (ORPHA:723)
- Dyspnea (HP:0002094): Difficult or labored breathing. Dyspnea is a subjective feeling only the patient can rate, e.g., on a Borg scale. Evidence: TAS. Frequency: Very frequent (HP:0040281). (ORPHA:723)
- Acute infectious pneumonia (HP:0011949): Acute inflammation of the lung due to an infection. Evidence: TAS. Frequency: Very frequent (HP:0040281). (ORPHA:723)
- Hypoxemia (HP:0012418): An abnormally low level of blood oxygen. Evidence: TAS. Frequency: Very frequent (HP:0040281). (ORPHA:723)
- Pneumocystis jirovecii pneumonia (HP:0020102): An opportunistic disease caused by invasion of unicellular fungus Pneumocystis jirovecii. Transmission of P. jirovecii cysts takes place through the airborne route, and usually, its presence in lungs is asymptomatic. However, people with impaired immunity, especially those with CD4+ T cell count below 200/microliter, are still at risk of the development of Pneumocystis pneumonia due to P. jirovecii invasion. Symptoms induced by this disease are not specific: progressive dyspnea, non-productive cough, low-grade fever, arterial partial pressure of oxygen below 65 mmHg, and chest radiographs demonstrating bilateral, interstitial shadowing. Evidence: TAS. Frequency: Very frequent (HP:0040281). (ORPHA:723)
- Weight loss (HP:0001824): Reduction of total body weight. Evidence: TAS. Frequency: Frequent (HP:0040282). (ORPHA:723)
- Respiratory insufficiency (HP:0002093). Evidence: TAS. Frequency: Frequent (HP:0040282). (ORPHA:723)
- Pleural effusion (HP:0002202): The presence of an excessive amount of fluid in the pleural cavity. Evidence: TAS. Frequency: Frequent (HP:0040282). (ORPHA:723)
- Immunodeficiency (HP:0002721): Failure of the immune system to protect the body adequately from infection, due to the absence or insufficiency of some component process or substance. Evidence: TAS. Frequency: Frequent (HP:0040282). (ORPHA:723)
- Exertional dyspnea (HP:0002875): Perceived difficulty to breathe that occurs with exercise or exertion and improves with rest. Evidence: TAS. Frequency: Frequent (HP:0040282). (ORPHA:723)
- Respiratory failure (HP:0002878): A severe form of respiratory insufficiency characterized by inadequate gas exchange such that the levels of oxygen or carbon dioxide cannot be maintained within normal limits. Evidence: TAS. Frequency: Frequent (HP:0040282). (ORPHA:723)
- Respiratory failure requiring assisted ventilation (HP:0004887): A state of respiratory distress that requires a life saving intervention in the form of gaining airway access and instituting positive pressure ventilation. Evidence: TAS. Frequency: Frequent (HP:0040282). (ORPHA:723)
- Interstitial pneumonitis (HP:0006515). Evidence: TAS. Frequency: Frequent (HP:0040282). (ORPHA:723)
- Increased circulating immunoglobulin concentration (HP:0010702): An increased level of gamma globulin (immunoglobulin) in the blood. Evidence: TAS. Frequency: Frequent (HP:0040282). (ORPHA:723)
- Abnormal total neutrophil count (HP:0011991): A deviation from the normal range of neutrophil cell counts in the circulation. Evidence: TAS. Frequency: Frequent (HP:0040282). (ORPHA:723)
- Combined cystic and ground-glass pattern on pulmonary HRCT (HP:0025395): Co-occurrence of the cystic pattern and the ground-glass pattern on pulmonary high-resolution computed tomography,. Evidence: TAS. Frequency: Frequent (HP:0040282). (ORPHA:723)
- Nonproductive cough (HP:0031246): A cough that does not produce phlegm or mucus. Evidence: TAS. Frequency: Frequent (HP:0040282). (ORPHA:723)
- Neoplasm (HP:0002664): An organ or organ-system abnormality that consists of uncontrolled autonomous cell-proliferation which can occur in any part of the body as a benign or malignant neoplasm (tumor). Evidence: TAS. Frequency: Occasional (HP:0040283). (ORPHA:723)
- Multiple pulmonary cysts (HP:0005948): The presence of multiple lung cysts. Evidence: TAS. Frequency: Occasional (HP:0040283). (ORPHA:723)
- Recurrent oral thrush (HP:0009098): Chronic accumulation and overgrowth of the fungus Candida albicans on the mucous membranes of the mouth, generally manifested as associated with creamy white lesions on the tongue or inner cheeks, occasionally spreading to the gums, tonsils, palate or oropharynx. Evidence: TAS. Frequency: Occasional (HP:0040283). (ORPHA:723)
- Increased circulating lactate dehydrogenase concentration (HP:0025435): An elevated level of the enzyme lactate dehydrogenase in the blood circulation. Evidence: TAS. Frequency: Occasional (HP:0040283). (ORPHA:723)
- Bloodstream infectious agent (HP:0031863): The presence of an infectious agent in the blood circulation. Evidence: TAS. Frequency: Occasional (HP:0040283). (ORPHA:723)
- Parenchymal consolidation (HP:0032177): Consolidation refers to an exudate or other product of disease that replaces alveolar air, rendering the lung solid (as in infective pneumonia). Evidence: TAS. Frequency: Occasional (HP:0040283). (ORPHA:723)
These phenotypes are associated with the disease Pneumocystosis (ORPHA:723).